- Anemia (HP:0001903): A reduction in erythrocytes volume or hemoglobin concentration. Evidence: TAS. Frequency: Very frequent (HP:0040281). (ORPHA:673)
- Acute kidney injury (HP:0001919): Sudden loss of renal function, as manifested by decreased urine production, and a rise in serum creatinine or blood urea nitrogen concentration (azotemia). Evidence: TAS. Frequency: Very frequent (HP:0040281). (ORPHA:673)
- Fever (HP:0001945): Body temperature elevated above the normal range. Evidence: TAS. Frequency: Very frequent (HP:0040281). (ORPHA:673)
- Morphological central nervous system abnormality (HP:0002011): A structural abnormality of the central nervous system. Evidence: TAS. Frequency: Very frequent (HP:0040281). (ORPHA:673)
- Nausea and vomiting (HP:0002017): Nausea is a commonly encountered symptom that has been defined as an unpleasant painless subjective feeling that one will imminently vomit. Vomiting has been defined as the forceful expulsion of the contents of the stomach, duodenum, or jejunum through the oral cavity. While nausea and vomiting are often thought to exist on a temporal continuum, this is not always the case. There are situations when severe nausea may be present without emesis and less frequently, when emesis may be present without preceding nausea. Evidence: TAS. Frequency: Very frequent (HP:0040281). (ORPHA:673)
- Headache (HP:0002315): Cephalgia, or pain sensed in various parts of the head, not confined to the area of distribution of any nerve. Evidence: TAS. Frequency: Very frequent (HP:0040281). (ORPHA:673)
- Elevated circulating C-reactive protein concentration (HP:0011227): The concentration of C-reactive protein in the blood circulation is above the upper limit of normal. Evidence: TAS. Frequency: Very frequent (HP:0040281). (ORPHA:673)
- Abnormality of blood and blood-forming tissues (HP:0001871): An abnormality of the hematopoietic system. Evidence: TAS. Frequency: Frequent (HP:0040282). (ORPHA:673)
- Thrombocytopenia (HP:0001873): A reduction in the number of circulating thrombocytes. Evidence: TAS. Frequency: Frequent (HP:0040282). (ORPHA:673)
- Respiratory distress (HP:0002098): Respiratory distress is objectively observable as the physical or emotional consequences from the experience of dyspnea. The physical presentation of respiratory distress is generally referred to as labored breathing, while the sensation of respiratory distress is called shortness of breath or dyspnea. Evidence: TAS. Frequency: Frequent (HP:0040282). (ORPHA:673)
- Gait imbalance (HP:0002141). Evidence: TAS. Frequency: Frequent (HP:0040282). (ORPHA:673)
- Hyperbilirubinemia (HP:0002904): An increased amount of bilirubin in the blood. Evidence: TAS. Frequency: Frequent (HP:0040282). (ORPHA:673)
- Myalgia (HP:0003326): Pain in muscle. Evidence: TAS. Frequency: Frequent (HP:0040282). (ORPHA:673)
- Reduced consciousness (HP:0004372): Abnormally diminished level of attention, responsiveness, or wakefulness. Evidence: TAS. Frequency: Frequent (HP:0040282). (ORPHA:673)
- Cognitive impairment (HP:0100543): Abnormal cognition is characterized by deficits in thinking, reasoning, or remembering. Evidence: TAS. Frequency: Frequent (HP:0040282). (ORPHA:673)
- Retinopathy (HP:0000488): Any noninflammatory disease of the retina. This nonspecific term is retained here because of its wide use in the literature, but if possible new annotations should indicate the precise type of retinal abnormality. Evidence: TAS. Frequency: Occasional (HP:0040283). (ORPHA:673)
These phenotypes are associated with the disease Malaria (ORPHA:673).